Phenotypes associated with the disease isolated right ventricular hypoplasia (OMIM:277200):
- Hypoplasia of right ventricle (HP:0004762): Underdevelopment or reduced size of the heart right ventricle, often due to a reduced number of cells. Evidence: IEA. (OMIM:277200)
- Autosomal recessive inheritance (HP:0000007): A mode of inheritance that is observed for traits related to a gene encoded on one of the autosomes (i.e., the human chromosomes 1-22) in which a trait manifests in individuals with two pathogenic alleles, either homozygotes (two copies of the same mutant allele) or compound heterozygotes (whereby each copy of a gene has a distinct mutant allele). Evidence: IEA. (OMIM:277200)